Phenotypes associated with the disease Acrorenal syndrome (ORPHA:971):
- Split hand (HP:0001171): A condition in which middle parts of the hand (fingers and metacarpals) are missing giving a cleft appearance. The severity is very variable ranging from slightly hypoplastic middle fingers over absent middle fingers as far as oligo- or monodactyl hands. Evidence: TAS. Frequency: Very frequent (HP:0040281). (ORPHA:971)
- Renal hypoplasia/aplasia (HP:0008678): Absence or underdevelopment of the kidney. Evidence: TAS. Frequency: Very frequent (HP:0040281). (ORPHA:971)
- Abnormal renal morphology (HP:0012210): Any structural anomaly of the kidney. Evidence: TAS. Frequency: Very frequent (HP:0040281). (ORPHA:971)
- Renal insufficiency (HP:0000083): A reduction in the level of performance of the kidneys in areas of function comprising the concentration of urine, removal of wastes, the maintenance of electrolyte balance, homeostasis of blood pressure, and calcium metabolism. Evidence: TAS. Frequency: Frequent (HP:0040282). (ORPHA:971)
- Abnormal tibia morphology (HP:0002992): Abnormality of the tibia (shinbone). Evidence: TAS. Frequency: Frequent (HP:0040282). (ORPHA:971)
- Aplasia/Hypoplasia of the radius (HP:0006501): A small/hypoplastic or absent/aplastic radius. Evidence: TAS. Frequency: Frequent (HP:0040282). (ORPHA:971)
- Abnormal morphology of ulna (HP:0040071): Any structural anomaly of the ulna, a bone of the forearm the extends from the elbow to the little finger. Evidence: TAS. Frequency: Frequent (HP:0040282). (ORPHA:971)
- Cleft palate (HP:0000175): Cleft palate is a developmental defect of the palate resulting from a failure of fusion of the palatine processes and manifesting as a separation of the roof of the mouth (soft and hard palate). Evidence: TAS. Frequency: Occasional (HP:0040283). (ORPHA:971)
- Micrognathia (HP:0000347): Developmental hypoplasia of the mandible. Evidence: TAS. Frequency: Occasional (HP:0040283). (ORPHA:971)
- Abnormality of the eye (HP:0000478): Any abnormality of the eye, including location, spacing, and intraocular abnormalities. Evidence: TAS. Frequency: Occasional (HP:0040283). (ORPHA:971)
- Abnormality of vision (HP:0000504): Abnormality of eyesight (visual perception). Evidence: TAS. Frequency: Occasional (HP:0040283). (ORPHA:971)